- Glycosuria (HP:0003076): An increased concentration of glucose in the urine. Evidence: IEA. (OMIM:138070)
- Hyperglycinuria (HP:0003108): An increased concentration of glycine in the urine. Evidence: IEA. (OMIM:138070)
- Autosomal dominant inheritance (HP:0000006): A mode of inheritance that is observed for traits related to a gene encoded on one of the autosomes (i.e., the human chromosomes 1-22) in which a trait manifests in heterozygotes. In the context of medical genetics, an autosomal dominant disorder is caused when a single copy of the mutant allele is present. Males and females are affected equally, and can both transmit the disorder with a risk of 50% for each child of inheriting the mutant allele. Evidence: IEA. (OMIM:138070)
These phenotypes are associated with the disease Glucoglycinuria (OMIM:138070).